- Abnormality of the skeletal system (HP:0000924): An abnormality of the skeletal system. Evidence: IEA. (OMIM:167600)
- Autosomal dominant inheritance (HP:0000006): A mode of inheritance that is observed for traits related to a gene encoded on one of the autosomes (i.e., the human chromosomes 1-22) in which a trait manifests in heterozygotes. In the context of medical genetics, an autosomal dominant disorder is caused when a single copy of the mutant allele is present. Males and females are affected equally, and can both transmit the disorder with a risk of 50% for each child of inheriting the mutant allele. Evidence: TAS. (OMIM:167600)
These phenotypes are associated with the disease palmaris longus muscle, absence of (OMIM:167600).